- Microcephaly (HP:0000252): Head circumference below 2 standard deviations below the mean for age and gender. Evidence: PCS. Frequency: 2/3. (PMID:32576952)
- Brachydactyly (HP:0001156): Digits that appear disproportionately short compared to the hand/foot. The word brachydactyly is used here to describe a series distinct patterns of shortened digits (brachydactyly types A-E). This is the sense used here. Evidence: PCS. Frequency: 1/3. (PMID:32576952)
- Hydrocele testis (HP:0000034): Accumulation of clear fluid in the between the layers of membrane (tunica vaginalis) surrounding the testis. Evidence: PCS. Frequency: 1/3. (PMID:32576952)
- Short stature (HP:0004322): A height below that which is expected according to age and gender norms. Although there is no universally accepted definition of short stature, many refer to "short stature" as height more than 2 standard deviations below the mean for age and gender (or below the 3rd percentile for age and gender dependent norms). Evidence: PCS. Frequency: 3/3. (PMID:32576952)
- Global developmental delay (HP:0001263): A delay in the achievement of motor or mental milestones in the domains of development of a child, including motor skills, speech and language, cognitive skills, and social and emotional skills. This term should only be used to describe children younger than five years of age. Evidence: PCS. Frequency: 3/3. (PMID:32576952)
- Infantile onset (HP:0003593): Onset of signs or symptoms of disease between 28 days to one year of life. Evidence: PCS. Frequency: 3/3. (PMID:32576952)
- Delayed gross motor development (HP:0002194): A type of motor delay characterized by a delay in acquiring the ability to control the large muscles of the body for walking, running, sitting, and crawling. Evidence: PCS. Frequency: 3/3. (PMID:32576952)
- Delayed fine motor development (HP:0010862): A type of motor delay characterized by a delay in acquiring the ability to control the fingers and hands. Evidence: PCS. Frequency: 1/3. (PMID:32576952)
- Adducted thumb (HP:0001181): In the resting position, the tip of the thumb is on, or near, the palm, close to the base of the fourth or fifth finger. Evidence: PCS. Frequency: 1/3. (PMID:32576952)
- Notched primary central incisor (HP:0012413): The presence of a V-shaped indentation (notch) in the primary central incisor. Evidence: PCS. Frequency: 1/1. (PMID:32576952)
- Muscular ventricular septal defect (HP:0011623): The trabecular septum is the largest part of the interventricular septum. It extends from the membranous septum to the apex and superiorly to the infundibular septum. A defect in the trabecular septum is called muscular VSD if the defect is completely rimmed by muscle. Evidence: PCS. Frequency: 1/3. (PMID:32576952)
- High anterior hairline (HP:0009890): Distance between the hairline (trichion) and the glabella (the most prominent point on the frontal bone above the root of the nose), in the midline, more than two SD above the mean. Alternatively, an apparently increased distance between the hairline and the glabella. Evidence: PCS. Frequency: 1/3. (PMID:32576952)
- Prominent forehead (HP:0011220): Forward prominence of the entire forehead, due to protrusion of the frontal bone. Evidence: PCS. Frequency: 3/3. (PMID:32576952)
- Sparse scalp hair (HP:0002209): Decreased number of hairs per unit area of skin of the scalp. Evidence: PCS. Frequency: 3/3. (PMID:32576952)
- Single transverse palmar crease (HP:0000954): The distal and proximal transverse palmar creases are merged into a single transverse palmar crease. Evidence: PCS. Frequency: 1/3. (PMID:32576952)
- Autosomal recessive inheritance (HP:0000007): A mode of inheritance that is observed for traits related to a gene encoded on one of the autosomes (i.e., the human chromosomes 1-22) in which a trait manifests in individuals with two pathogenic alleles, either homozygotes (two copies of the same mutant allele) or compound heterozygotes (whereby each copy of a gene has a distinct mutant allele). Evidence: PCS. (PMID:32576952)
- Macrocephaly (HP:0000256): Occipitofrontal (head) circumference greater than 97th centile compared to appropriate, age matched, sex-matched normal standards. Alternatively, a apparently increased size of the cranium. Evidence: PCS. Frequency: 1/3. (PMID:32576952)
- Low-set ears (HP:0000369): Upper insertion of the ear to the scalp below an imaginary horizontal line drawn between the inner canthi of the eye and extending posteriorly to the ear. Evidence: PCS. Frequency: 3/3. (PMID:32576952)
These phenotypes are associated with the disease developmental delay with short stature, dysmorphic facial features, and sparse hair 2 (OMIM:620062).